Phenotypes associated with the disease orofacial cleft 3 (OMIM:600757):
- Abnormality of the face (HP:0000271): An abnormality of the face. Evidence: IEA. (OMIM:600757)
- Autosomal dominant inheritance (HP:0000006): A mode of inheritance that is observed for traits related to a gene encoded on one of the autosomes (i.e., the human chromosomes 1-22) in which a trait manifests in heterozygotes. In the context of medical genetics, an autosomal dominant disorder is caused when a single copy of the mutant allele is present. Males and females are affected equally, and can both transmit the disorder with a risk of 50% for each child of inheriting the mutant allele. Evidence: TAS. (OMIM:600757)